Phenotypes associated with the disease paroxysmal nocturnal hemoglobinuria 1 (OMIM:300818):
- Typified by somatic mosaicism (HP:0001442): Description of conditions in which affected individuals typically display somatic mosaicism, i.e., genetically distinct populations of somatic cells in a given organism caused by DNA mutations, epigenetic alterations of DNA, chromosomal abnormalities or the spontaneous reversion of inherited mutations. In many conditions typified by somatic mosaicism, constitutive mutation is lethal and cases are exclusively or predominantly mosaic. Evidence: PCS. (PMID:8306954)
- Adult onset (HP:0003581): Onset of disease manifestations in adulthood, defined here as at the age of 16 years or later. Evidence: PCS. (PMID:25244093)
- Paroxysmal nocturnal hemoglobinuria (HP:0004818). Evidence: PCS. (PMID:8306954)